- Pancreatic calcification (HP:0005213): The presence of abnormal calcium deposition lesions in the pancreas. Evidence: TAS. Frequency: Very frequent (HP:0040281). (ORPHA:103918)
- Chronic calcifying pancreatitis (HP:0005236): A form of chronic pancreatitis that is characterized by calcification. Evidence: TAS. Frequency: Very frequent (HP:0040281). (ORPHA:103918)
- Epigastric pain (HP:0410019): Pain that is localized to the region of the upper abdomen immediately below the ribs. Evidence: TAS. Frequency: Very frequent (HP:0040281). (ORPHA:103918)
- Nausea (HP:0002018): A sensation of unease in the stomach together with an urge to vomit. Evidence: TAS. Frequency: Frequent (HP:0040282). (ORPHA:103918)
- Insulin-dependent but ketosis-resistant diabetes (HP:0008205): Ketosis-resistant diabetes is a synonym for type II diabetes. This term thus refers to a form of type II diabetes in which patients are dependent on insulin. Evidence: TAS. Frequency: Frequent (HP:0040282). (ORPHA:103918)
- Abnormal pancreatic duct morphology (HP:0030992): Any structural anomaly of the pancreatic duct, which is the tubular structure that collects exocrine pancreatic secretions and transports them to the duodenum. Evidence: TAS. Frequency: Frequent (HP:0040282). (ORPHA:103918)
- Jaundice (HP:0000952): Yellow pigmentation of the skin due to bilirubin, which in turn is the result of increased bilirubin concentration in the bloodstream. Evidence: TAS. Frequency: Occasional (HP:0040283). (ORPHA:103918)
- Weight loss (HP:0001824): Reduction of total body weight. Evidence: TAS. Frequency: Occasional (HP:0040283). (ORPHA:103918)
- Vomiting (HP:0002013): Forceful ejection of the contents of the stomach through the mouth by means of a series of involuntary spasmic contractions. Evidence: TAS. Frequency: Occasional (HP:0040283). (ORPHA:103918)
- Malnutrition (HP:0004395): A deficiency in the intake of energy and nutrients. Evidence: TAS. Frequency: Occasional (HP:0040283). (ORPHA:103918)
- Pancreatic adenocarcinoma (HP:0006725): The presence of an adenocarcinoma of the pancreas. Evidence: TAS. Frequency: Occasional (HP:0040283). (ORPHA:103918)
- Maternal diabetes (HP:0009800): Maternal diabetes can either be a gestational, mostly type 2 diabetes, or a type 1 diabetes. Essential is the resulting maternal hyperglycemia as a non-specific teratogen, imposing the same risk of congenital malformations to pregnant women with both type 1 and type2 diabetes. Evidence: TAS. Frequency: Occasional (HP:0040283). (ORPHA:103918)
These phenotypes are associated with the disease Tropical pancreatitis (ORPHA:103918).